Phenotypes associated with the disease spinal muscular atrophy with microcephaly and mental subnormality (OMIM:271110):
- Microcephaly (HP:0000252): Head circumference below 2 standard deviations below the mean for age and gender. Evidence: IEA. (OMIM:271110)
- Proximal spinal muscular atrophy (HP:0006959): Proximal spinal muscular atrophy, i.e., muscular weakness and atrophy related to loss of the motor neurons of the spinal cord and brainstem. Evidence: IEA. (OMIM:271110)
- Autosomal recessive inheritance (HP:0000007): A mode of inheritance that is observed for traits related to a gene encoded on one of the autosomes (i.e., the human chromosomes 1-22) in which a trait manifests in individuals with two pathogenic alleles, either homozygotes (two copies of the same mutant allele) or compound heterozygotes (whereby each copy of a gene has a distinct mutant allele). Evidence: IEA. (OMIM:271110)
- Intellectual disability (HP:0001249): The term intellectual disability or intellectual developmental disorder is used to describe significantly sub-average intellectual and adaptive functioning based on clinical assessment and as measured by individually administered, appropriately normed, standardized and validated tests of intellectual functioning and adaptive behavior, with onset during the developmental period from infancy through adolescence. Evidence: IEA. (OMIM:271110)